Phenotypes associated with the disease Ophthalmoplegia-intellectual disability-lingua scrotalis syndrome (ORPHA:2743):
- Furrowed tongue (HP:0000221): Accentuation of the grooves on the dorsal surface of the tongue. Evidence: TAS. Frequency: Very frequent (HP:0040281). (ORPHA:2743)
- Ptosis (HP:0000508): The upper eyelid margin is positioned 3 mm or more lower than usual and covers the superior portion of the iris (objective); or, the upper lid margin obscures at least part of the pupil (subjective). Evidence: TAS. Frequency: Very frequent (HP:0040281). (ORPHA:2743)
- Ophthalmoparesis (HP:0000597): Ophthalmoplegia is a paralysis or weakness of one or more of the muscles that control eye movement. Evidence: TAS. Frequency: Very frequent (HP:0040281). (ORPHA:2743)
- Ophthalmoplegia (HP:0000602): Paralysis of one or more extraocular muscles that are responsible for eye movements. Evidence: TAS. Frequency: Very frequent (HP:0040281). (ORPHA:2743)
- Intellectual disability (HP:0001249): The term intellectual disability or intellectual developmental disorder is used to describe significantly sub-average intellectual and adaptive functioning based on clinical assessment and as measured by individually administered, appropriately normed, standardized and validated tests of intellectual functioning and adaptive behavior, with onset during the developmental period from infancy through adolescence. Evidence: TAS. Frequency: Very frequent (HP:0040281). (ORPHA:2743)
- Global developmental delay (HP:0001263): A delay in the achievement of motor or mental milestones in the domains of development of a child, including motor skills, speech and language, cognitive skills, and social and emotional skills. This term should only be used to describe children younger than five years of age. Evidence: TAS. Frequency: Very frequent (HP:0040281). (ORPHA:2743)
- Specific learning disability (HP:0001328): Impairment of certain skills such as reading or writing, coordination, self-control, or attention that interfere with the ability to learn. The impairment is not related to a global deficiency of intelligence. Evidence: TAS. Frequency: Very frequent (HP:0040281). (ORPHA:2743)
- Abnormal retinal pigmentation (HP:0007703): Any deviation from the normal pigmentation of the retina. Evidence: TAS. Frequency: Very frequent (HP:0040281). (ORPHA:2743)
- Oculomotor nerve palsy (HP:0012246): Reduced ability to control the movement of the eye associated with damage to the third cranial nerve (the oculomotor nerve). Evidence: TAS. Frequency: Very frequent (HP:0040281). (ORPHA:2743)
- Myopia (HP:0000545): An abnormality of refraction characterized by the ability to see objects nearby clearly, while objects in the distance appear blurry. Evidence: TAS. Frequency: Frequent (HP:0040282). (ORPHA:2743)
- Facial palsy (HP:0010628): Facial nerve palsy is a dysfunction of cranial nerve VII (the facial nerve) that results in inability to control facial muscles on the affected side with weakness of the muscles of facial expression and eye closure. This can either be present in unilateral or bilateral form. Evidence: TAS. Frequency: Frequent (HP:0040282). (ORPHA:2743)
- Abnormal electroretinogram (HP:0000512): Any abnormality of the electrical responses of various cell types in the retina as measured by electroretinography. Evidence: TAS. Frequency: Occasional (HP:0040283). (ORPHA:2743)
- Hemiplegia (HP:0002301): Paralysis (complete loss of muscle function) in the arm, leg, and in some cases the face on one side of the body. Evidence: TAS. Frequency: Occasional (HP:0040283). (ORPHA:2743)